- Hearing impairment (HP:0000365): A decreased magnitude of the sensory perception of sound. Evidence: TAS. (OMIM:614414)
- Autosomal recessive inheritance (HP:0000007): A mode of inheritance that is observed for traits related to a gene encoded on one of the autosomes (i.e., the human chromosomes 1-22) in which a trait manifests in individuals with two pathogenic alleles, either homozygotes (two copies of the same mutant allele) or compound heterozygotes (whereby each copy of a gene has a distinct mutant allele). Evidence: TAS. (OMIM:614414)
These phenotypes are associated with the disease autosomal recessive nonsyndromic hearing loss 96 (OMIM:614414).